Phenotypes associated with the disease triglyceride storage disease, type 1 (OMIM:190420):
- Decreased body weight (HP:0004325): Abnormally low body weight. Evidence: TAS. (OMIM:190420)
- Microcephaly (HP:0000252): Head circumference below 2 standard deviations below the mean for age and gender. Evidence: TAS. (OMIM:190420)